- Abnormal hair morphology (HP:0001595): An abnormality of the hair. Evidence: PCS. Frequency: 0/1. (PMID:40924475)
- Microcephaly (HP:0000252): Head circumference below 2 standard deviations below the mean for age and gender. Evidence: PCS. Frequency: 1/1. (PMID:40924475)
- Multiple lentigines (HP:0001003): Presence of an unusually high number of lentigines (singular: lentigo), which are flat, tan to brown oval spots. Evidence: PCS. Frequency: 1/1. (PMID:40924475)
- Cutaneous photosensitivity (HP:0000992): An increased sensitivity of the skin to light. Photosensitivity may result in a rash upon exposure to the sun (which is known as photodermatosis). Photosensitivity can be diagnosed by phototests in which light is shone on small areas of skin. Evidence: PCS. Frequency: 1/1. (PMID:40924475)
- Abnormal nail morphology (HP:0001597): Abnormal structure or appearance of the nail. Evidence: PCS. Frequency: 0/1. (PMID:40924475)
- Delayed speech and language development (HP:0000750): A degree of language development that is significantly below the norm for a child of a specified age. Evidence: PCS. Frequency: 1/1. (PMID:40924475)
- Mild intellectual disability (HP:0001256): Mild intellectual disability (ID) is defined as a type of ID characterized by mildly sub-average adaptive functioning and intellectual functioning, with an intelligence quotient (IQ) the range of 50-69. Evidence: PCS. Frequency: 1/1. (PMID:40924475)
- Decreased total leukocyte count (HP:0001882): An abnormal decreased number of leukocytes in the blood. Evidence: PCS. Frequency: 0/1. (PMID:40924475)
- Delayed ability to walk (HP:0031936): A failure to achieve the ability to walk at an appropriate developmental stage. Most children learn to walk in a series of stages, and learn to walk short distances independently between 12 and 15 months. Evidence: PCS. Frequency: 1/1. (PMID:40924475)
- Delayed skeletal maturation (HP:0002750): A decreased rate of skeletal maturation. Delayed skeletal maturation can be diagnosed on the basis of an estimation of the bone age from radiographs of specific bones in the human body. Evidence: PCS. Frequency: 0/1. (PMID:40924475)
- Short stature (HP:0004322): A height below that which is expected according to age and gender norms. Although there is no universally accepted definition of short stature, many refer to "short stature" as height more than 2 standard deviations below the mean for age and gender (or below the 3rd percentile for age and gender dependent norms). Evidence: PCS. Frequency: 0/1. (PMID:40924475)
- Deeply set eye (HP:0000490): An eye that is more deeply recessed into the plane of the face than is typical. Evidence: PCS. Frequency: 0/1. (PMID:40924475)
- Infantile onset (HP:0003593): Onset of signs or symptoms of disease between 28 days to one year of life. Evidence: PCS. Frequency: 1/1. (PMID:40924475)
- Erythema (HP:0010783): Redness of the skin, caused by hyperemia of the capillaries in the lower layers of the skin. Evidence: PCS. Frequency: 1/1. (PMID:40924475)
- Scarring (HP:0100699): A scar refers to a lesion in which wound, burn, or sore has not healed completely and fibrous connective tissue has developed. Evidence: PCS. Frequency: 1/1. (PMID:40924475)
- Ichthyosis (HP:0008064): An abnormality of the skin characterized the presence of excessive amounts of dry surface scales on the skin resulting from an abnormality of keratinization. Evidence: PCS. Frequency: 0/1. (PMID:40924475)
- Dry skin (HP:0000958): Skin characterized by the lack of natural or normal moisture. Evidence: PCS. Frequency: 0/1. (PMID:40924475)
- Small for gestational age (HP:0001518): Smaller than normal size according to sex and gestational age related norms, defined as a weight below the 10th percentile for the gestational age. Evidence: PCS. Frequency: 1/1. (PMID:40924475)
- Anemia (HP:0001903): A reduction in erythrocytes volume or hemoglobin concentration. Evidence: PCS. Frequency: 0/1. (PMID:40924475)
- Mild global developmental delay (HP:0011342): A mild delay in the achievement of motor or mental milestones in the domains of development of a child. Evidence: PCS. Frequency: 1/1. (PMID:40924475)
- Photophobia (HP:0000613): Excessive sensitivity to light with the sensation of discomfort or pain in the eyes due to exposure to bright light. Evidence: PCS. Frequency: 1/1. (PMID:40924475)
- Autosomal recessive inheritance (HP:0000007): A mode of inheritance that is observed for traits related to a gene encoded on one of the autosomes (i.e., the human chromosomes 1-22) in which a trait manifests in individuals with two pathogenic alleles, either homozygotes (two copies of the same mutant allele) or compound heterozygotes (whereby each copy of a gene has a distinct mutant allele). Evidence: PCS. (PMID:40924475)
- Falls (HP:0002527). Evidence: PCS. Frequency: 1/1. (PMID:40924475)
- Pterygium (HP:0001059): Pterygia are 'winglike' triangular membranes occurring in the neck, eyes, knees, elbows, ankles or digits. Evidence: PCS. Frequency: 0/1. (PMID:40924475)
These phenotypes are associated with the disease xeroderma pigmentosum, complementation group J (OMIM:621435).